- Autosomal recessive inheritance (HP:0000007): A mode of inheritance that is observed for traits related to a gene encoded on one of the autosomes (i.e., the human chromosomes 1-22) in which a trait manifests in individuals with two pathogenic alleles, either homozygotes (two copies of the same mutant allele) or compound heterozygotes (whereby each copy of a gene has a distinct mutant allele). Evidence: IEA. (OMIM:219300)
- Cutis gyrata of scalp (HP:0010541): The presence of convoluted folds and furrows formed from thickened skin of the scalp, resembling cerebriform pattern. The scalp has convoluted and elevated folds, 1 to 2 cm in thickness. The convolutions generally cannot be flattened by traction. Evidence: IEA. (OMIM:219300)
- Intellectual disability (HP:0001249): The term intellectual disability or intellectual developmental disorder is used to describe significantly sub-average intellectual and adaptive functioning based on clinical assessment and as measured by individually administered, appropriately normed, standardized and validated tests of intellectual functioning and adaptive behavior, with onset during the developmental period from infancy through adolescence. Evidence: IEA. (OMIM:219300)
These phenotypes are associated with the disease cutis verticis gyrata and intellectual disability (OMIM:219300).